- Weight loss (HP:0001824): Reduction of total body weight. Evidence: TAS. Frequency: Frequent (HP:0040282). (ORPHA:2552)
- Abdominal pain (HP:0002027): An unpleasant sensation characterized by physical discomfort (such as pricking, throbbing, or aching) and perceived to originate in the abdomen. Evidence: TAS. Frequency: Frequent (HP:0040282). (ORPHA:2552)
- Chronic diarrhea (HP:0002028): The presence of chronic diarrhea, which is usually taken to mean diarrhea that has persisted for over 4 weeks. Evidence: TAS. Frequency: Frequent (HP:0040282). (ORPHA:2552)
- Intermittent diarrhea (HP:0002254): Repeated episodes of diarrhea separated by periods without diarrhea. Evidence: TAS. Frequency: Frequent (HP:0040282). (ORPHA:2552)
- Immunodeficiency (HP:0002721): Failure of the immune system to protect the body adequately from infection, due to the absence or insufficiency of some component process or substance. Evidence: TAS. Frequency: Frequent (HP:0040282). (ORPHA:2552)
- Sinusitis (HP:0000246): Inflammation of the paranasal sinuses owing to a viral, bacterial, or fungal infection, allergy, or an autoimmune reaction. Evidence: TAS. Frequency: Occasional (HP:0040283). (ORPHA:2552)
- Fever (HP:0001945): Body temperature elevated above the normal range. Evidence: TAS. Frequency: Occasional (HP:0040283). (ORPHA:2552)
- Vomiting (HP:0002013): Forceful ejection of the contents of the stomach through the mouth by means of a series of involuntary spasmic contractions. Evidence: TAS. Frequency: Occasional (HP:0040283). (ORPHA:2552)
- Nausea (HP:0002018): A sensation of unease in the stomach together with an urge to vomit. Evidence: TAS. Frequency: Occasional (HP:0040283). (ORPHA:2552)
- Anorexia (HP:0002039): Lack of desire to eat (loss of appetite). Evidence: TAS. Frequency: Occasional (HP:0040283). (ORPHA:2552)
- Abnormality of the urinary system physiology (HP:0011277). Evidence: TAS. Frequency: Occasional (HP:0040283). (ORPHA:2552)
- Rhinitis (HP:0012384): Inflammation of the nasal mucosa with nasal congestion. Evidence: TAS. Frequency: Occasional (HP:0040283). (ORPHA:2552)
- Bronchitis (HP:0012387): Inflammation of the large airways in the lung including any part of the bronchi from the primary bronchi to the tertiary bronchi. Evidence: TAS. Frequency: Occasional (HP:0040283). (ORPHA:2552)
- Prostatitis (HP:0000024): The presence of inflammation of the prostate. Evidence: TAS. Frequency: Very rare (HP:0040284). (ORPHA:2552)
- Nephritis (HP:0000123): The presence of inflammation affecting the kidney. Evidence: TAS. Frequency: Very rare (HP:0040284). (ORPHA:2552)
- Glossitis (HP:0000206): Inflammation of the tongue. Evidence: TAS. Frequency: Very rare (HP:0040284). (ORPHA:2552)
- Keratitis (HP:0000491): Inflammation of the cornea. Evidence: TAS. Frequency: Very rare (HP:0040284). (ORPHA:2552)
- Visual loss (HP:0000572): Loss of visual acuity (implying that vision was better at a certain time point in life). Otherwise the term reduced visual acuity should be used (or a subclass of that). Evidence: TAS. Frequency: Very rare (HP:0040284). (ORPHA:2552)
- Abnormality of the parathyroid gland (HP:0000828): An abnormality of the parathyroid gland. Evidence: TAS. Frequency: Very rare (HP:0040284). (ORPHA:2552)
- Adrenocortical abnormality (HP:0000849). Evidence: TAS. Frequency: Very rare (HP:0040284). (ORPHA:2552)
- Biliary tract abnormality (HP:0001080): An abnormality of the biliary tree. Evidence: TAS. Frequency: Very rare (HP:0040284). (ORPHA:2552)
- Keratoconjunctivitis (HP:0001096): Inflammation of the cornea and conjunctiva. Evidence: TAS. Frequency: Very rare (HP:0040284). (ORPHA:2552)
- Seizure (HP:0001250): A seizure is an intermittent abnormality of nervous system physiology characterized by a transient occurrence of signs and/or symptoms due to abnormal excessive or synchronous neuronal activity in the brain. Evidence: TAS. Frequency: Very rare (HP:0040284). (ORPHA:2552)
- Pancreatitis (HP:0001733): The presence of inflammation in the pancreas. Evidence: TAS. Frequency: Very rare (HP:0040284). (ORPHA:2552)
- Abnormality of the spleen (HP:0001743): An abnormality of the spleen. Evidence: TAS. Frequency: Very rare (HP:0040284). (ORPHA:2552)
- Dehydration (HP:0001944). Evidence: TAS. Frequency: Very rare (HP:0040284). (ORPHA:2552)
- Pneumonia (HP:0002090): Inflammation of any part of the lung parenchyma. Evidence: TAS. Frequency: Very rare (HP:0040284). (ORPHA:2552)
- Infectious encephalitis (HP:0002383): A disorder of the brain caused by an infectious agent that presents with fever, headache, and an altered level of consciousness. There may also be focal or multifocal neurologic deficits, and focal or generalized seizure activity. Evidence: TAS. Frequency: Very rare (HP:0040284). (ORPHA:2552)
- Peritonitis (HP:0002586): Inflammation of the peritoneum. Evidence: TAS. Frequency: Very rare (HP:0040284). (ORPHA:2552)
- Osteomyelitis (HP:0002754): Osteomyelitis is an inflammatory process accompanied by bone destruction and caused by an infecting microorganism. Evidence: TAS. Frequency: Very rare (HP:0040284). (ORPHA:2552)
- Abnormal tracheal morphology (HP:0002778): A structural anomaly of the trachea. Evidence: TAS. Frequency: Very rare (HP:0040284). (ORPHA:2552)
- Lymphadenitis (HP:0002840): Inflammation of a lymph node. Evidence: TAS. Frequency: Very rare (HP:0040284). (ORPHA:2552)
- Cachexia (HP:0004326): Severe weight loss, wasting of muscle, loss of appetite, and general debility related to a chronic disease. Evidence: TAS. Frequency: Very rare (HP:0040284). (ORPHA:2552)
- Abnormal bone marrow cell morphology (HP:0005561): An anomaly of the form or number of cells in the bone marrow. Evidence: TAS. Frequency: Very rare (HP:0040284). (ORPHA:2552)
- Abnormal vocal cord morphology (HP:0008777): An abnormality of the vocal cord. Evidence: TAS. Frequency: Very rare (HP:0040284). (ORPHA:2552)
- Abnormal fallopian tube morphology (HP:0011027): An abnormality of the fallopian tube. Evidence: TAS. Frequency: Very rare (HP:0040284). (ORPHA:2552)
- Unusual bronchiolitis (HP:0011950): Increased susceptibility to bronchiolitis (inflammation of the bronchioles) as manifested by recurrent or severe epsiodes of bronchiolitis. Evidence: TAS. Frequency: Very rare (HP:0040284). (ORPHA:2552)
- Hepatitis (HP:0012115): Inflammation of the liver. Evidence: TAS. Frequency: Very rare (HP:0040284). (ORPHA:2552)
- Corneal ulceration (HP:0012804): Disruption of the epithelial layer of the cornea with involvement of the underlying stroma. Evidence: TAS. Frequency: Very rare (HP:0040284). (ORPHA:2552)
- Myocarditis (HP:0012819): Inflammation of the myocardium. Evidence: TAS. Frequency: Very rare (HP:0040284). (ORPHA:2552)
- Pharyngitis (HP:0025439): Inflammation (due to infection or irritation) of the pharynx. Evidence: TAS. Frequency: Very rare (HP:0040284). (ORPHA:2552)
- Brain abscess (HP:0030049): A collection of pus, immune cells, and other material in the brain. Evidence: TAS. Frequency: Very rare (HP:0040284). (ORPHA:2552)
- Abnormal endometrium morphology (HP:0030126): An anomaly of the inner mucous membrane of the uterus. Evidence: TAS. Frequency: Very rare (HP:0040284). (ORPHA:2552)
- Cholangitis (HP:0030151): Inflammation of the biliary ductal system, affecting the intrahepatic or extrahepatic portions, or both. Evidence: TAS. Frequency: Very rare (HP:0040284). (ORPHA:2552)
- Endocarditis (HP:0100584): An inflammation of the endocardium, the inner layer of the heart, which usually involves the heart valves. Evidence: TAS. Frequency: Very rare (HP:0040284). (ORPHA:2552)
- Myositis (HP:0100614): A general term for inflammation of the muscles without respect to the underlying cause. Evidence: TAS. Frequency: Very rare (HP:0040284). (ORPHA:2552)
- Thyroiditis (HP:0100646): Inflammation of the thyroid gland. Evidence: TAS. Frequency: Very rare (HP:0040284). (ORPHA:2552)
- Sepsis (HP:0100806): Sepsis is defined as life-threatening organ dysfunction caused by a dysregulated host response to infection. Evidence: TAS. Frequency: Very rare (HP:0040284). (ORPHA:2552)
- Skin nodule (HP:0200036): Morphologically similar to a papule, but greater than either 10mm in both width and depth, and most frequently centered in the dermis or subcutaneous fat. Evidence: TAS. Frequency: Very rare (HP:0040284). (ORPHA:2552)
- Urethritis (HP:0500006): Inflammation of the urethra. Evidence: TAS. Frequency: Very rare (HP:0040284). (ORPHA:2552)
- Decreased total CD4+ T cell proportion (HP:0032218): Abnormal decrease of helper CD3+CD4+ T cells, measured as percentage of total CD3+ T cells in the blood, compared to a reference range for a given sex and age-group. These are usually measured within the TCR alpha/beta positive population. Evidence: TAS. Frequency: Frequent (HP:0040282). (ORPHA:2552)
These phenotypes are associated with the disease Microsporidiosis (ORPHA:2552).